Phenotypes associated with the disease blepharochalasis, superior (OMIM:110000):
- Blepharochalasis (HP:0010749): Blepharochalasis is characterized by recurrent, non-painful, nonerythematous episodes of eyelid edema. It has been divided into hypertrophic and atrophic forms. In the hypertrophic form recurrent edema results in orbital fat herniation through a weakened orbital septum. Most patients who have blepharochalasis present in an atrophic condition with atrophy of redundant eyelid skin and superior nasal fat pads. Evidence: TAS. (OMIM:110000)
- Autosomal dominant inheritance (HP:0000006): A mode of inheritance that is observed for traits related to a gene encoded on one of the autosomes (i.e., the human chromosomes 1-22) in which a trait manifests in heterozygotes. In the context of medical genetics, an autosomal dominant disorder is caused when a single copy of the mutant allele is present. Males and females are affected equally, and can both transmit the disorder with a risk of 50% for each child of inheriting the mutant allele. Evidence: TAS. (OMIM:110000)